- Otosclerosis (HP:0000362): In otosclerosis, a callus of bone accumulates on the stapes creating a partial fixation. This limits the movement of the stapes bone, which results in hearing loss. Evidence: IEA. (OMIM:615589)
- Autosomal dominant inheritance (HP:0000006): A mode of inheritance that is observed for traits related to a gene encoded on one of the autosomes (i.e., the human chromosomes 1-22) in which a trait manifests in heterozygotes. In the context of medical genetics, an autosomal dominant disorder is caused when a single copy of the mutant allele is present. Males and females are affected equally, and can both transmit the disorder with a risk of 50% for each child of inheriting the mutant allele. Evidence: TAS. (OMIM:615589)
These phenotypes are associated with the disease otosclerosis 10 (OMIM:615589).